- Abnormality of the nervous system (HP:0000707): An abnormality of the nervous system. Evidence: IEA. (OMIM:108390)
- Autosomal dominant inheritance (HP:0000006): A mode of inheritance that is observed for traits related to a gene encoded on one of the autosomes (i.e., the human chromosomes 1-22) in which a trait manifests in heterozygotes. In the context of medical genetics, an autosomal dominant disorder is caused when a single copy of the mutant allele is present. Males and females are affected equally, and can both transmit the disorder with a risk of 50% for each child of inheriting the mutant allele. Evidence: TAS. (OMIM:108390)
These phenotypes are associated with the disease ASPARAGUS, SPECIFIC SMELL HYPERSENSITIVITY (OMIM:108390).